Phenotypes associated with the disease nasal bones, absence of (OMIM:161480):
- Abnormality of the face (HP:0000271): An abnormality of the face. Evidence: IEA. (OMIM:161480)
- Short columella (HP:0002000): Reduced distance from the anterior border of the naris to the subnasale. Evidence: TAS. (OMIM:161480)
- Narrow naris (HP:0009933): Slender, slit-like aperture of the nostril. Evidence: TAS. (OMIM:161480)
- Autosomal dominant inheritance (HP:0000006): A mode of inheritance that is observed for traits related to a gene encoded on one of the autosomes (i.e., the human chromosomes 1-22) in which a trait manifests in heterozygotes. In the context of medical genetics, an autosomal dominant disorder is caused when a single copy of the mutant allele is present. Males and females are affected equally, and can both transmit the disorder with a risk of 50% for each child of inheriting the mutant allele. Evidence: IEA. (OMIM:161480)